- Overgrowth (HP:0001548): Excessive postnatal growth which may comprise increased weight, increased length, and/or increased head circumference. Evidence: TAS. Frequency: Obligate (HP:0040280). (ORPHA:276280)
- Macrodactyly (HP:0004099): Significant increase in the length and girth of most or all of a digit compared to its contralateral digit (if unaffected) or compared to what would be expected for age/body build. The increased girth is accompanied by an increase in the dorso-ventral dimension AND the lateral dimension of the digit. Evidence: TAS. Frequency: Frequent (HP:0040282). (ORPHA:276280)
- Abnormal cerebral vascular morphology (HP:0100659): An anomaly of the cerebral blood vessels. Evidence: TAS. Frequency: Frequent (HP:0040282). (ORPHA:276280)
- Hydrocele testis (HP:0000034): Accumulation of clear fluid in the between the layers of membrane (tunica vaginalis) surrounding the testis. Evidence: TAS. Frequency: Occasional (HP:0040283). (ORPHA:276280)
- Enlarged kidney (HP:0000105): An abnormal increase in the size of the kidney. Evidence: TAS. Frequency: Occasional (HP:0040283). (ORPHA:276280)
- Multiple lipomas (HP:0001012): The presence of multiple lipomas (a type of benign tissue made of fatty tissue). Evidence: TAS. Frequency: Occasional (HP:0040283). (ORPHA:276280)
- Seborrheic dermatitis (HP:0001051): Seborrheic dermatitis is a form of eczema which is closely related to dandruff. It causes dry or greasy peeling of the scalp, eyebrows, and face, and sometimes trunk. Evidence: TAS. Frequency: Occasional (HP:0040283). (ORPHA:276280)
- Foot polydactyly (HP:0001829): A kind of polydactyly characterized by the presence of a supernumerary toe or toes. Evidence: TAS. Frequency: Occasional (HP:0040283). (ORPHA:276280)
- Abnormal venous morphology (HP:0002624): An anomaly of vein. Evidence: TAS. Frequency: Occasional (HP:0040283). (ORPHA:276280)
- Scoliosis (HP:0002650): The presence of an abnormal lateral curvature of the spine. Evidence: TAS. Frequency: Occasional (HP:0040283). (ORPHA:276280)
- Nevus (HP:0003764): A nevus is a type of hamartoma that is a circumscribed stable malformation of the skin. Evidence: TAS. Frequency: Occasional (HP:0040283). (ORPHA:276280)
- Microtia (HP:0008551): Underdevelopment of the external ear. Evidence: TAS. Frequency: Occasional (HP:0040283). (ORPHA:276280)
- 2-4 toe syndactyly (HP:0010714): Syndactyly with fusion of toes two to four. Evidence: TAS. Frequency: Occasional (HP:0040283). (ORPHA:276280)
- Ovarian serous cystadenoma (HP:0012887): A cystic tumor of the ovary, containing thin, clear, yellow serous fluid and varying amounts of solid tissue. Evidence: TAS. Frequency: Occasional (HP:0040283). (ORPHA:276280)
- Hyperparakeratosis (HP:0040009): Histological term to illustrate the combined presence of parakeratosis and hyperkeratosis. Abnormal keratinization of the epidermal stratum corneum (horny layer) with increased keratin formation and preservation of the nuclei in the superficial cells. Evidence: TAS. Frequency: Occasional (HP:0040283). (ORPHA:276280)
- Lipoatrophy (HP:0100578): Localized loss of fat tissue. Evidence: TAS. Frequency: Occasional (HP:0040283). (ORPHA:276280)
- Telangiectasia of the skin (HP:0100585): Presence of small, permanently dilated blood vessels near the surface of the skin, visible as small focal red lesions. Evidence: TAS. Frequency: Occasional (HP:0040283). (ORPHA:276280)
- Abnormality of the lymphatic system (HP:0100763): An anomaly of the lymphatic system, a network of lymphatic vessels that carry a clear fluid called lymph unidirectionally towards either the right lymphatic duct or the thoracic duct, which in turn drain into the right and left subclavian veins respectively. Evidence: TAS. Frequency: Occasional (HP:0040283). (ORPHA:276280)
- Nephroblastoma (HP:0002667): The presence of a nephroblastoma, which is a neoplasm of the kidney that primarily affects children. Evidence: TAS. Frequency: Very rare (HP:0040284). (ORPHA:276280)
These phenotypes are associated with the disease Hemihyperplasia-multiple lipomatosis syndrome (ORPHA:276280).